- Bilateral tonic-clonic seizure (HP:0002069): A bilateral tonic-clonic seizure is a seizure defined by a tonic (bilateral increased tone, lasting seconds to minutes) and then a clonic (bilateral sustained rhythmic jerking) phase. Evidence: PCS. Frequency: 6/8. (PMID:38579670)
- Focal clonic seizure (HP:0002266): A focal clonic seizure is a type of focal motor seizure characterized by sustained rhythmic jerking, that is regularly repetitive. Evidence: PCS. Frequency: 2/9. (PMID:38579670)
- Generalized-onset seizure (HP:0002197): A generalized-onset seizure is a type of seizure originating at some point within, and rapidly engaging, bilaterally distributed networks. The networks may include cortical and subcortical structures but not necessarily the entire cortex. Evidence: PCS. Frequency: 1/1. (PMID:38579670)
- Generalized non-motor (absence) seizure (HP:0002121): A generalized non-motor (absence) seizure is a type of a type of dialeptic seizure that is of electrographically generalized onset. It is a generalized seizure characterized by an interruption of activities, a blank stare, and usually the person will be unresponsive when spoken to. Any ictal motor phenomena are minor in comparison to these non-motor features. Evidence: PCS. Frequency: 1/9. (PMID:38579670)
- Hypotonia (HP:0001252): Hypotonia is an abnormally low muscle tone (the amount of tension or resistance to movement in a muscle). Even when relaxed, muscles have a continuous and passive partial contraction which provides some resistance to passive stretching. Hypotonia thus manifests as diminished resistance to passive stretching. Hypotonia is not the same as muscle weakness, although the two conditions can co-exist. Evidence: PCS. Frequency: 9/9. (PMID:38579670)
- Infantile onset (HP:0003593): Onset of signs or symptoms of disease between 28 days to one year of life. Evidence: PCS. Frequency: 7/8. (PMID:38579670)
- Myoclonic seizure (HP:0032794): A myoclonic seizure is a type of motor seizure characterized by sudden, brief (<100 ms) involuntary single or multiple contraction of muscles or muscle groups of variable topography (axial, proximal limb, distal). Myoclonus is less regularly repetitive and less sustained than is clonus. Evidence: PCS. Frequency: 2/2. (PMID:38579670)
- Profound global developmental delay (HP:0012736): A profound delay in the achievement of motor or mental milestones in the domains of development of a child. Evidence: PCS. Frequency: 9/9. (PMID:38579670)
- Thin corpus callosum (HP:0033725): An abnormally thin corpus callous, due to atrophy, hypoplasia or agenesis. This term is intended to be used in situations where it is not known if thinning of the corpus callosum (for instance, as visualized by magnetic resonance tomography) is due to abnormal development (e.g. a leukodystrophy) or atrophy following normal development (e.g. neurodegeneration). Evidence: PCS. Frequency: 5/7. (PMID:38579670)
- Infantile spasms (HP:0012469): Infantile spasms represent a subset of "epileptic spasms". Infantile Spasms are epileptic spasms starting in the first year of life (infancy). Evidence: PCS. Frequency: 1/9. (PMID:38579670)
- Dilation of Virchow-Robin spaces (HP:0012520): Increased dimensions of the Virchow-Robin spaces (also known as perivascular spaces), which surround the walls of vessels as they course from the subarachnoid space through the brain parenchyma. Perivascular spaces are commonly microscopic, and not visible on conventional neuroimaging. This term refers to an increase of size of these spaces such that they are visible on neuroimaging (usually magnetic resonance imaging). The dilatations are regular cavities that always contain a patent artery. Evidence: PCS. Frequency: 5/7. (PMID:38579670)
- Focal myoclonic seizure (HP:0011166): A type of focal motor seizure characterized by sudden, brief (<100 ms) involuntary single or multiple contraction(s) of muscles(s) or muscle groups of variable topography (axial, proximal limb, distal). Myoclonus is less regularly repetitive and less sustained than is clonus. Evidence: PCS. Frequency: 1/9. (PMID:38579670)
- Childhood onset (HP:0011463): Onset of disease at the age of between 1 and 5 years. Evidence: PCS. Frequency: 1/8. (PMID:38579670)
- Tonic seizure (HP:0032792): A tonic seizure is a type of motor seizure characterized by unilateral or bilateral limb stiffening or elevation, often with neck stiffening. Evidence: PCS. Frequency: 2/9. (PMID:38579670)
- Hypoglutaminemia (HP:0500147): The concentration of glutamine in the blood circulation is below the lower limit of normal. Evidence: PCS. Frequency: 2/8. (PMID:38579670)
- Epileptic encephalopathy (HP:0200134): A condition in which epileptiform abnormalities are believed to contribute to the progressive disturbance in cerebral function. Epileptic encephalaopathy is characterized by (1) electrographic EEG paroxysmal activity that is often aggressive, (2) seizures that are usually multiform and intractable, (3) cognitive, behavioral and neurological deficits that may be relentless, and (4) sometimes early death. Evidence: PCS. Frequency: 8/8. (PMID:38579670)
- CNS hypomyelination (HP:0003429): Reduced amount of myelin in the central nervous system resulting from defective myelinogenesis. Evidence: PCS. Frequency: 7/7. (PMID:38579670)
- Generalized myoclonic-atonic seizure (HP:0011170): A generalized myoclonic-atonic seizure is a type of generalized motor seizure characterized by a myoclonic jerk followed by an atonic motor component. Evidence: PCS. Frequency: 1/9. (PMID:38579670)
- Focal-onset seizure (HP:0007359): A focal-onset seizure is a type of seizure originating within networks limited to one hemisphere. They may be discretely localized or more widely distributed, and may originate in subcortical structures. Evidence: PCS. Frequency: 1/1. (PMID:38579670)
- Decreased CSF glutamine concentration (HP:0500198): Abnormally decreased levels of glutamine in cerebrospinal fluid. Evidence: PCS. Frequency: 2/7. (PMID:38579670)
- Autosomal dominant inheritance (HP:0000006): A mode of inheritance that is observed for traits related to a gene encoded on one of the autosomes (i.e., the human chromosomes 1-22) in which a trait manifests in heterozygotes. In the context of medical genetics, an autosomal dominant disorder is caused when a single copy of the mutant allele is present. Males and females are affected equally, and can both transmit the disorder with a risk of 50% for each child of inheriting the mutant allele. Evidence: PCS. (PMID:38579670)
These phenotypes are associated with the disease developmental and epileptic encephalopathy 116 (OMIM:620806).